- Hypotension (HP:0002615): Low Blood Pressure, vascular hypotension. Evidence: TAS. Frequency: Very frequent (HP:0040281). (ORPHA:97292)
- Abnormal EKG (HP:0003115): Abnormal rhythm of the heart. Evidence: TAS. Frequency: Very frequent (HP:0040281). (ORPHA:97292)
- Abnormal left ventricular function (HP:0005162): Inability of the left ventricle to perform its normal physiologic function. Failure is either due to an inability to contract the left ventricle or the inability to relax completely and fill with blood during diastole. Evidence: TAS. Frequency: Very frequent (HP:0040281). (ORPHA:97292)
- Low-output congestive heart failure (HP:0009805): A form of heart failure characterized by reduced cardiac output. This may be seen in patients with heart failure owing to ischemic heart disease, hypertension, cardiomyopathy, and other causes. Evidence: TAS. Frequency: Very frequent (HP:0040281). (ORPHA:97292)
- Cyanosis (HP:0000961): Bluish discoloration of the skin and mucosa due to poor circulation or inadequate oxygenation of arterial or capillary blood. Evidence: TAS. Frequency: Frequent (HP:0040282). (ORPHA:97292)
- Edema (HP:0000969): An abnormal accumulation of fluid beneath the skin, or in one or more cavities of the body. Evidence: TAS. Frequency: Frequent (HP:0040282). (ORPHA:97292)
- Congestive heart failure (HP:0001635): The presence of an abnormality of cardiac function that is responsible for the failure of the heart to pump blood at a rate that is commensurate with the needs of the tissues or a state in which abnormally elevated filling pressures are required for the heart to do so. Heart failure is frequently related to a defect in myocardial contraction. Evidence: TAS. Frequency: Frequent (HP:0040282). (ORPHA:97292)
- Myocardial infarction (HP:0001658): Necrosis of the myocardium caused by an obstruction of the blood supply to the heart and often associated with chest pain, shortness of breath, palpitations, and anxiety as well as characteristic EKG findings and elevation of serum markers including creatine kinase-MB fraction and troponin. Evidence: TAS. Frequency: Frequent (HP:0040282). (ORPHA:97292)
- Cardiac arrest (HP:0001695): An abrupt loss of heart function. Evidence: TAS. Frequency: Frequent (HP:0040282). (ORPHA:97292)
- Dyspnea (HP:0002094): Difficult or labored breathing. Dyspnea is a subjective feeling only the patient can rate, e.g., on a Borg scale. Evidence: TAS. Frequency: Frequent (HP:0040282). (ORPHA:97292)
- Reduced consciousness (HP:0004372): Abnormally diminished level of attention, responsiveness, or wakefulness. Evidence: TAS. Frequency: Frequent (HP:0040282). (ORPHA:97292)
- Impaired myocardial contractility (HP:0006670). Evidence: TAS. Frequency: Frequent (HP:0040282). (ORPHA:97292)
- Arrhythmia (HP:0011675): Any cardiac rhythm other than the normal sinus rhythm. Such a rhythm may be either of sinus or ectopic origin and either regular or irregular. An arrhythmia may be due to a disturbance in impulse formation or conduction or both. Evidence: TAS. Frequency: Frequent (HP:0040282). (ORPHA:97292)
- Hypoxemia (HP:0012418): An abnormally low level of blood oxygen. Evidence: TAS. Frequency: Frequent (HP:0040282). (ORPHA:97292)
- Orthopnea (HP:0012764): A sensation of breathlessness in the recumbent position, relieved by sitting or standing. Evidence: TAS. Frequency: Frequent (HP:0040282). (ORPHA:97292)
- Crackles (HP:0030830): Crackles are discontinuous, explosive, and nonmusical adventitious lung sounds normally heard in inspiration and sometimes during expiration. Crackles are usually classified as fine and coarse crackles based on their duration, loudness, pitch, timing in the respiratory cycle, and relationship to coughing and changing body position. Evidence: TAS. Frequency: Frequent (HP:0040282). (ORPHA:97292)
- Elevated jugular venous pressure (HP:0030848): Increased jugular venous pressure. Evidence: TAS. Frequency: Frequent (HP:0040282). (ORPHA:97292)
- Low pulse pressure (HP:0030851): Reduced amplitude of the pulse pressure (systolic blood pressure minus diastolic blood pressure). Evidence: TAS. Frequency: Frequent (HP:0040282). (ORPHA:97292)
- Increased pulmonary capillary wedge pressure (HP:0030876): Pulmonary capillary wedge pressure (PCWP) above 15mmHg. Evidence: TAS. Frequency: Frequent (HP:0040282). (ORPHA:97292)
- Oliguria (HP:0100520): Low output of urine, clinically classified as an output below 300-500ml/day. Evidence: TAS. Frequency: Frequent (HP:0040282). (ORPHA:97292)
- Confusion (HP:0001289): Lack of clarity and coherence of thought, perception, understanding, or action. Evidence: TAS. Frequency: Occasional (HP:0040283). (ORPHA:97292)
- Mitral regurgitation (HP:0001653): An abnormality of the mitral valve characterized by insufficiency or incompetence of the mitral valve resulting in retrograde leaking of blood through the mitral valve upon ventricular contraction. Evidence: TAS. Frequency: Occasional (HP:0040283). (ORPHA:97292)
- Metabolic acidosis (HP:0001942): Metabolic acidosis (MA) is characterized by a fall in blood pH due to a reduction of serum bicarbonate concentration. This can occur as a result of either the accumulation of acids (high anion gap MA) or the loss of bicarbonate from the gastrointestinal tract or the kidney (hyperchloremic MA). By definition, MA is not due to a respirary cause. Evidence: TAS. Frequency: Occasional (HP:0040283). (ORPHA:97292)
- Increased circulating lactate concentration (HP:0002151): Abnormally increased level of blood lactate (2-hydroxypropanoic acid). Lactate is produced from pyruvate by lactate dehydrogenase during normal metabolism. The terms lactate and lactic acid are often used interchangeably but lactate (the component measured in blood) is strictly a weak base whereas lactic acid is the corresponding acid. Lactic acidosis is often used clinically to describe elevated lactate but should be reserved for cases where there is a corresponding acidosis (pH below 7.35). Evidence: TAS. Frequency: Occasional (HP:0040283). (ORPHA:97292)
- Hepatomegaly (HP:0002240): Abnormally increased size of the liver. Evidence: TAS. Frequency: Occasional (HP:0040283). (ORPHA:97292)
- Vertigo (HP:0002321): An abnormal sensation of spinning while the body is actually stationary. Evidence: TAS. Frequency: Occasional (HP:0040283). (ORPHA:97292)
- Elevated circulating creatinine concentration (HP:0003259): An increased amount of creatinine in the blood. Evidence: TAS. Frequency: Occasional (HP:0040283). (ORPHA:97292)
- ST segment elevation (HP:0012251): An electrocardiographic anomaly in which the ST segment is observed to be located superior to the isoelectric line. Evidence: TAS. Frequency: Occasional (HP:0040283). (ORPHA:97292)
- Coma (HP:0001259): The complete absence of wakefulness and consciousness, which is evident through a lack of response to any form of external stimuli. Evidence: TAS. Frequency: Very rare (HP:0040284). (ORPHA:97292)
- Right ventricular failure (HP:0001708): Reduced ability of the right ventricle to perform its function (to receive blood from the right atrium and to eject blood into the pulmonary artery), often leading to pitting peripheral edema, ascites, and hepatomegaly. Evidence: TAS. Frequency: Very rare (HP:0040284). (ORPHA:97292)
These phenotypes are associated with the disease Cardiogenic shock (ORPHA:97292).